Phenotypes associated with the disease pancreatic cancer, susceptibility to, 3 (OMIM:613348):
- Pancreatic adenocarcinoma (HP:0006725): The presence of an adenocarcinoma of the pancreas. Evidence: PCS. (PMID:19264984)
- Adult onset (HP:0003581): Onset of disease manifestations in adulthood, defined here as at the age of 16 years or later. Evidence: PCS. (PMID:19264984)
- Autosomal dominant inheritance (HP:0000006): A mode of inheritance that is observed for traits related to a gene encoded on one of the autosomes (i.e., the human chromosomes 1-22) in which a trait manifests in heterozygotes. In the context of medical genetics, an autosomal dominant disorder is caused when a single copy of the mutant allele is present. Males and females are affected equally, and can both transmit the disorder with a risk of 50% for each child of inheriting the mutant allele. Evidence: PCS. (PMID:19264984)